Phenotypes associated with the disease pigmented nodular adrenocortical disease, primary, 2 (OMIM:610475):
- Osteoporosis (HP:0000939): Osteoporosis is a systemic skeletal disease characterized by low bone density and microarchitectural deterioration of bone tissue with a consequent increase in bone fragility. According to the WHO criteria, osteoporosis is defined as a BMD that lies 2.5 standard deviations or more below the average value for young healthy adults (a T-score below -2.5 SD). Evidence: IEA. (OMIM:610475)
- Depression (HP:0000716): Frequently experiencing feelings of being down, miserable, and/or hopeless; struggling to recover from these moods; having a pessimistic outlook on the future; feeling a pervasive sense of shame; having a low self-worth; experiencing thoughts of suicide and engaging in suicidal behavior. Evidence: IEA. (OMIM:610475)
- Osteopenia (HP:0000938): Osteopenia is a term to define bone density that is not normal but also not as low as osteoporosis. By definition from the World Health Organization osteopenia is defined by bone densitometry as a T score -1 to -2.5. Evidence: IEA. (OMIM:610475)
- Young adult onset (HP:0011462): Onset of disease at the age of between 16 and 40 years. Evidence: PCS. Frequency: 3/4. (PMID:16767104)
- Anxiety (HP:0000739): Intense feelings of nervousness, tension, or panic often arise in response to interpersonal stresses. There is worry about the negative effects of past unpleasant experiences and future negative possibilities. Individuals may feel fearful, apprehensive, or threatened by uncertainty, and they may also have fears of falling apart or losing control. Evidence: IEA. (OMIM:610475)
- Emotional lability (HP:0000712): Unstable emotional experiences and frequent mood changes; emotions that are easily aroused, intense, and/or disproportionate to events and circumstances. Evidence: IEA. (OMIM:610475)
- Bruising susceptibility (HP:0000978): An ecchymosis (bruise) refers to the skin discoloration caused by the escape of blood into the tissues from ruptured blood vessels. This term refers to an abnormally increased susceptibility to bruising. The corresponding phenotypic abnormality is generally elicited on medical history as a report of frequent ecchymoses or bruising without adequate trauma. Evidence: IEA. (OMIM:610475)
- Agitation (HP:0000713): A state of excessive motor activity that is associated with mental distress or a feeling of substantial unease or inner tension. Distinguished from restlessness by the increased level of emotional distress and negative intensity of the experience. Agitation has a significant level of physical activity that is typically threatening to the self or others. Evidence: IEA. (OMIM:610475)
- Round face (HP:0000311): The facial appearance is more circular than usual as viewed from the front. Evidence: IEA. (OMIM:610475)
- Mental deterioration (HP:0001268): Loss of previously present mental abilities, generally in adults. Evidence: IEA. (OMIM:610475)
- Ovarian cyst (HP:0000138): The presence of one or more cysts of the ovary. Evidence: PCS. Frequency: 1/4. (PMID:16767104)
- Paradoxical increased cortisol secretion on dexamethasone suppression test (HP:0003466). Evidence: IEA. (OMIM:610475)
- Juvenile onset (HP:0003621): Onset of signs or symptoms of disease between the age of 5 and 15 years. Evidence: PCS. Frequency: 1/4. (PMID:16767104)
- Pigmented micronodular adrenocortical disease (HP:0001580). Evidence: PCS. Frequency: 4/4. (PMID:16767104)
- Striae distensae (HP:0001065): Thinned, erythematous, depressed bands of atrophic skin. Initially, striae appear as flattened and thinned, pinkish linear regions of the skin. Striae tend to enlarge in length and become reddish or purplish. Later, striae tend to appear as white, depressed bands that are parallel to the lines of skin tension. Striae distensae occur most often in areas that have been subject to distension such as the lower back, buttocks, thighs, breast, abdomen, and shoulders. Evidence: IEA. (OMIM:610475)
- Psychosis (HP:0000709): A condition characterized by changes in personality and thought patterns, often accompanied by hallucinations and delusional beliefs, is known as psychosis. Evidence: IEA. (OMIM:610475)
- Kyphosis (HP:0002808): Exaggerated anterior convexity of the thoracic vertebral column. Evidence: IEA. (OMIM:610475)
- Hypertension (HP:0000822): The presence of chronic increased pressure in the systemic arterial system. Evidence: IEA. (OMIM:610475)
- Truncal obesity (HP:0001956): Obesity located preferentially in the trunk of the body as opposed to the extremities. Evidence: IEA. (OMIM:610475)
- Increased circulating cortisol level (HP:0003118): Overproduction of the hormone of cortisol by the adrenal cortex, resulting in a characteristic combination of clinical symptoms termed Cushing syndrome, with truncal obesity, a round, full face, striae atrophicae and acne, muscle weakness, and other features. Evidence: IEA. Frequency: 3/4. (OMIM:610475)
- Decreased circulating ACTH concentration (HP:0002920): The concentration of corticotropin, also known as adrenocorticotropic hormone (ACTH), is below the lower limit of normal in the blood circulation. Evidence: IEA. (OMIM:610475)
- Thin skin (HP:0000963): Reduction in thickness of the skin, generally associated with a loss of suppleness and elasticity of the skin. Evidence: IEA. (OMIM:610475)
- Primary hypercortisolism (HP:0001579): Hypercortisolemia associated with a primary defect of the adrenal gland leading to overproduction of cortisol. Evidence: IEA. (OMIM:610475)
- Autosomal dominant inheritance (HP:0000006): A mode of inheritance that is observed for traits related to a gene encoded on one of the autosomes (i.e., the human chromosomes 1-22) in which a trait manifests in heterozygotes. In the context of medical genetics, an autosomal dominant disorder is caused when a single copy of the mutant allele is present. Males and females are affected equally, and can both transmit the disorder with a risk of 50% for each child of inheriting the mutant allele. Evidence: PCS. (PMID:16767104)
- Pancreatitis (HP:0001733): The presence of inflammation in the pancreas. Evidence: PCS. Frequency: 1/4. (PMID:16767104)